Phenotypes associated with the disease strabismus, susceptibility to (OMIM:185100):
- Microtropia (HP:0031724): A small angle heterotropia (usually of 10 diopters or less) in which a form of binocular single vision occurs. Evidence: IEA. (OMIM:185100)
- Strabismus (HP:0000486): A misalignment of the eyes so that the visual axes deviate from bifoveal fixation. The classification of strabismus may be based on a number of features including the relative position of the eyes, whether the deviation is latent or manifest, intermittent or constant, concomitant or otherwise and according to the age of onset and the relevance of any associated refractive error. Evidence: IEA. (OMIM:185100)